- Microcephaly (HP:0000252): Head circumference below 2 standard deviations below the mean for age and gender. Evidence: TAS. (OMIM:614347)
- Moderate intellectual disability (HP:0002342): Moderate intellectual disability (ID) is defined as a type of ID characterized by moderately sub-average adaptive functioning and intellectual functioning, with an intelligence quotient (IQ) the range of 35-49. Evidence: TAS. (OMIM:614347)
- Delayed speech and language development (HP:0000750): A degree of language development that is significantly below the norm for a child of a specified age. Evidence: TAS. (OMIM:614347)
- Autosomal recessive inheritance (HP:0000007): A mode of inheritance that is observed for traits related to a gene encoded on one of the autosomes (i.e., the human chromosomes 1-22) in which a trait manifests in individuals with two pathogenic alleles, either homozygotes (two copies of the same mutant allele) or compound heterozygotes (whereby each copy of a gene has a distinct mutant allele). Evidence: TAS. (OMIM:614347)
- Motor delay (HP:0001270): A type of Developmental delay characterized by a delay in acquiring motor skills. Evidence: TAS. (OMIM:614347)
These phenotypes are associated with the disease intellectual disability, autosomal recessive 28 (OMIM:614347).